Phenotypes associated with the disease Ackerman syndrome (OMIM:200970):
- Taurodontia (HP:0000679): Increased volume of dental pulp of permanent molar characterized by a crown body-root ratio equal or larger than 1:1 or an elongated pulp chambers and apical displacement of the bifurcation or trifurcation of the roots. Evidence: IEA. (OMIM:200970)
- Autosomal recessive inheritance (HP:0000007): A mode of inheritance that is observed for traits related to a gene encoded on one of the autosomes (i.e., the human chromosomes 1-22) in which a trait manifests in individuals with two pathogenic alleles, either homozygotes (two copies of the same mutant allele) or compound heterozygotes (whereby each copy of a gene has a distinct mutant allele). Evidence: IEA. (OMIM:200970)
- Broad philtrum (HP:0000289): Distance between the philtral ridges, measured just above the vermilion border, more than 2 standard deviations above the mean, or alternatively, an apparently increased distance between the ridges of the philtrum. Evidence: TAS. (OMIM:200970)
- Glaucoma (HP:0000501): Glaucoma refers loss of retinal ganglion cells in a characteristic pattern of optic neuropathy usually associated with increased intraocular pressure. Evidence: TAS. (OMIM:200970)